Phenotypes associated with the disease microcephaly-cervical spine fusion anomalies syndrome (OMIM:251250):
- Microcephaly (HP:0000252): Head circumference below 2 standard deviations below the mean for age and gender. Evidence: IEA. (OMIM:251250)
- Short stature (HP:0004322): A height below that which is expected according to age and gender norms. Although there is no universally accepted definition of short stature, many refer to "short stature" as height more than 2 standard deviations below the mean for age and gender (or below the 3rd percentile for age and gender dependent norms). Evidence: IEA. (OMIM:251250)
- Spinal cord compression (HP:0002176): External mechanical compression of the spinal cord. Evidence: IEA. (OMIM:251250)
- Vertebral fusion (HP:0002948): A developmental defect leading to the union of two adjacent vertebrae. Evidence: IEA. (OMIM:251250)
- Spinal instability (HP:0005881). Evidence: IEA. (OMIM:251250)
- Autosomal recessive inheritance (HP:0000007): A mode of inheritance that is observed for traits related to a gene encoded on one of the autosomes (i.e., the human chromosomes 1-22) in which a trait manifests in individuals with two pathogenic alleles, either homozygotes (two copies of the same mutant allele) or compound heterozygotes (whereby each copy of a gene has a distinct mutant allele). Evidence: IEA. (OMIM:251250)
- Intellectual disability (HP:0001249): The term intellectual disability or intellectual developmental disorder is used to describe significantly sub-average intellectual and adaptive functioning based on clinical assessment and as measured by individually administered, appropriately normed, standardized and validated tests of intellectual functioning and adaptive behavior, with onset during the developmental period from infancy through adolescence. Evidence: IEA. (OMIM:251250)